- Thick lower lip vermilion (HP:0000179): Increased thickness of the lower lip, leading to a prominent appearance of the lower lip. The height of the vermilion of the lower lip in the midline is more than 2 SD above the mean. Alternatively, an apparently increased height of the vermilion of the lower lip in the frontal view (subjective). Evidence: TAS. Frequency: Very frequent (HP:0040281). (ORPHA:1221)
- Neoplasm (HP:0002664): An organ or organ-system abnormality that consists of uncontrolled autonomous cell-proliferation which can occur in any part of the body as a benign or malignant neoplasm (tumor). Evidence: TAS. Frequency: Very frequent (HP:0040281). (ORPHA:1221)
- Squamous cell carcinoma (HP:0002860): The presence of squamous cell carcinoma of the skin. Evidence: TAS. Frequency: Very frequent (HP:0040281). (ORPHA:1221)
- Abnormal salivary gland morphology (HP:0010286): Any abnormality of the salivary glands, the exocrine glands that produce saliva. Evidence: TAS. Frequency: Very frequent (HP:0040281). (ORPHA:1221)
- Abnormality of immune system physiology (HP:0010978): A functional abnormality of the immune system. Evidence: TAS. Frequency: Very frequent (HP:0040281). (ORPHA:1221)
These phenotypes are associated with the disease Cheilitis glandularis (ORPHA:1221).